Phenotypes associated with the disease restless legs syndrome, susceptibility to, 1 (OMIM:102300):
- Paresthesia (HP:0003401): Abnormal sensations such as tingling, pricking, or numbness of the skin with no apparent physical cause. Evidence: TAS. (OMIM:102300)
- Restless legs (HP:0012452): An irresistible urge to move the legs, usually accompanied by unpleasant sensations deep within the limbs. Symptoms typically begin or worsen during periods of rest or inactivity, are most pronounced in the evening or at night, and are temporarily relieved by movement such as walking or stretching. The disturbance often interferes with the initiation or maintenance of sleep. Evidence: TAS. (OMIM:102300)
- Insomnia (HP:0100785): Persistent difficulty in starting or maintaining sleep, or waking up earlier than desired, despite having adequate opportunities and conditions for sleep. Evidence: TAS. (OMIM:102300)
- Sleep disturbance (HP:0002360): An abnormal pattern in the quality, quantity, or characteristics of sleep. Evidence: TAS. (OMIM:102300)
- Exercise-induced leg cramps (HP:0008991): Sudden and involuntary contractions of one or more muscles of the leg brought on by physical exertion. Evidence: TAS. (OMIM:102300)
- Autosomal dominant inheritance (HP:0000006): A mode of inheritance that is observed for traits related to a gene encoded on one of the autosomes (i.e., the human chromosomes 1-22) in which a trait manifests in heterozygotes. In the context of medical genetics, an autosomal dominant disorder is caused when a single copy of the mutant allele is present. Males and females are affected equally, and can both transmit the disorder with a risk of 50% for each child of inheriting the mutant allele. Evidence: TAS. (OMIM:102300)
- Myoclonus (HP:0001336): Very brief, involuntary random muscular contractions occurring at rest, in response to sensory stimuli, or accompanying voluntary movements. Evidence: TAS. (OMIM:102300)